- Hyporeflexia (HP:0001265): Reduction of neurologic reflexes such as the knee-jerk reaction. Evidence: IEA. (OMIM:103100)
- Tonic pupil (HP:0012074): An abnormality of the pupillary light reaction characterized by a marked slowing of the light reaction of usually just one pupil. The pupil tends to be relatively dilated, and there is reduced accommodation. Evidence: TAS. (OMIM:103100)
- Autosomal dominant inheritance (HP:0000006): A mode of inheritance that is observed for traits related to a gene encoded on one of the autosomes (i.e., the human chromosomes 1-22) in which a trait manifests in heterozygotes. In the context of medical genetics, an autosomal dominant disorder is caused when a single copy of the mutant allele is present. Males and females are affected equally, and can both transmit the disorder with a risk of 50% for each child of inheriting the mutant allele. Evidence: IEA. (OMIM:103100)
These phenotypes are associated with the disease Holmes-Adie syndrome (OMIM:103100).